Phenotypes associated with the disease Chitotriosidase deficiency (OMIM:614122):
- Autosomal recessive inheritance (HP:0000007): A mode of inheritance that is observed for traits related to a gene encoded on one of the autosomes (i.e., the human chromosomes 1-22) in which a trait manifests in individuals with two pathogenic alleles, either homozygotes (two copies of the same mutant allele) or compound heterozygotes (whereby each copy of a gene has a distinct mutant allele). Evidence: TAS. (OMIM:614122)